- Otosclerosis (HP:0000362): In otosclerosis, a callus of bone accumulates on the stapes creating a partial fixation. This limits the movement of the stapes bone, which results in hearing loss. Evidence: IEA. (OMIM:617898)
- Brachydactyly (HP:0001156): Digits that appear disproportionately short compared to the hand/foot. The word brachydactyly is used here to describe a series distinct patterns of shortened digits (brachydactyly types A-E). This is the sense used here. Evidence: IEA. Frequency: Very rare (HP:0040284). (OMIM:617898)
- Overlapping toe (HP:0001845): Describes a foot digit resting on the dorsal surface of an adjacent digit when the foot is at rest. Initially clawing may be dynamic and only noticeable on walking. Over time the plantar plate tears, subluxation occurs at the metatarsophalangeal joint (MTPJ), and the deformity becomes permanent. Evidence: IEA. (OMIM:617898)
- Broad foot (HP:0001769): A foot for which the measured width is above the 95th centile for age; or, a foot that appears disproportionately wide for its length. Evidence: IEA. (OMIM:617898)
- Tarsal synostosis (HP:0008368): Synostosis (bony fusion) involving one or more bones of the tarsus (calcaneus, talus, cuboid, navicular, cuneiiform bones). Evidence: IEA. (OMIM:617898)
- Pes planus (HP:0001763): A foot where the longitudinal arch of the foot is in contact with the ground or floor when the individual is standing; or, in a patient lying supine, a foot where the arch is in contact with the surface of a flat board pressed against the sole of the foot by the examiner with a pressure similar to that expected from weight bearing; or, the height of the arch is reduced. Evidence: IEA. (OMIM:617898)
- Autosomal dominant inheritance (HP:0000006): A mode of inheritance that is observed for traits related to a gene encoded on one of the autosomes (i.e., the human chromosomes 1-22) in which a trait manifests in heterozygotes. In the context of medical genetics, an autosomal dominant disorder is caused when a single copy of the mutant allele is present. Males and females are affected equally, and can both transmit the disorder with a risk of 50% for each child of inheriting the mutant allele. Evidence: IEA. (OMIM:617898)
These phenotypes are associated with the disease multiple synostoses syndrome 4 (OMIM:617898).